Phenotypes associated with the disease hearing loss, autosomal dominant 89 (OMIM:620284):
- Congenital onset (HP:0003577): A phenotypic abnormality that is present at birth. Evidence: PCS. (PMID:33111345)
- Hearing impairment (HP:0000365): A decreased magnitude of the sensory perception of sound. Evidence: PCS. (PMID:33111345)
- Childhood onset (HP:0011463): Onset of disease at the age of between 1 and 5 years. Evidence: PCS. (PMID:33111345)
- Autosomal dominant inheritance (HP:0000006): A mode of inheritance that is observed for traits related to a gene encoded on one of the autosomes (i.e., the human chromosomes 1-22) in which a trait manifests in heterozygotes. In the context of medical genetics, an autosomal dominant disorder is caused when a single copy of the mutant allele is present. Males and females are affected equally, and can both transmit the disorder with a risk of 50% for each child of inheriting the mutant allele. Evidence: PCS. (PMID:33111345)